- Abnormal heart valve morphology (HP:0001654): Any structural abnormality of a cardiac valve. Evidence: TAS. Frequency: Very frequent (HP:0040281). (ORPHA:3287)
- Weight loss (HP:0001824): Reduction of total body weight. Evidence: TAS. Frequency: Very frequent (HP:0040281). (ORPHA:3287)
- Fever (HP:0001945): Body temperature elevated above the normal range. Evidence: TAS. Frequency: Very frequent (HP:0040281). (ORPHA:3287)
- Vascular dilatation (HP:0002617): An abnormal increase in the diameter of an artery or vein, either as a diffuse dilatation or as a localized, sac-like outpouching of the vessel wall (aneurysm). Evidence: TAS. Frequency: Very frequent (HP:0040281). (ORPHA:3287)
- Vasculitis (HP:0002633): Inflammation of blood vessel. Evidence: TAS. Frequency: Very frequent (HP:0040281). (ORPHA:3287)
- Arteritis (HP:0012089): Arterial inflammation. Evidence: TAS. Frequency: Very frequent (HP:0040281). (ORPHA:3287)
- Fatigue (HP:0012378): A subjective feeling of tiredness characterized by a lack of energy and motivation. Evidence: TAS. Frequency: Very frequent (HP:0040281). (ORPHA:3287)
- Arterial stenosis (HP:0100545): Narrowing or constriction of the inner surface (lumen) of an artery. Evidence: TAS. Frequency: Very frequent (HP:0040281). (ORPHA:3287)
- Hypertensive crisis (HP:0100735). Evidence: TAS. Frequency: Very frequent (HP:0040281). (ORPHA:3287)
- Hypertension (HP:0000822): The presence of chronic increased pressure in the systemic arterial system. Evidence: TAS. Frequency: Frequent (HP:0040282). (ORPHA:3287)
- Seizure (HP:0001250): A seizure is an intermittent abnormality of nervous system physiology characterized by a transient occurrence of signs and/or symptoms due to abnormal excessive or synchronous neuronal activity in the brain. Evidence: TAS. Frequency: Frequent (HP:0040282). (ORPHA:3287)
- Muscle weakness (HP:0001324): Reduced strength of muscles. Evidence: TAS. Frequency: Frequent (HP:0040282). (ORPHA:3287)
- Arthritis (HP:0001369): Inflammation of a joint. Evidence: TAS. Frequency: Frequent (HP:0040282). (ORPHA:3287)
- Abnormal aortic valve morphology (HP:0001646): Any abnormality of the aortic valve. Evidence: TAS. Frequency: Frequent (HP:0040282). (ORPHA:3287)
- Myocardial infarction (HP:0001658): Necrosis of the myocardium caused by an obstruction of the blood supply to the heart and often associated with chest pain, shortness of breath, palpitations, and anxiety as well as characteristic EKG findings and elevation of serum markers including creatine kinase-MB fraction and troponin. Evidence: TAS. Frequency: Frequent (HP:0040282). (ORPHA:3287)
- Anemia (HP:0001903): A reduction in erythrocytes volume or hemoglobin concentration. Evidence: TAS. Frequency: Frequent (HP:0040282). (ORPHA:3287)
- Renal artery stenosis (HP:0001920): The presence of stenosis of the renal artery. Evidence: TAS. Frequency: Frequent (HP:0040282). (ORPHA:3287)
- Anorexia (HP:0002039): Lack of desire to eat (loss of appetite). Evidence: TAS. Frequency: Frequent (HP:0040282). (ORPHA:3287)
- Migraine (HP:0002076): Migraine is a chronic neurological disorder characterized by episodic attacks of headache and associated symptoms. Evidence: TAS. Frequency: Frequent (HP:0040282). (ORPHA:3287)
- Pulmonary arterial hypertension (HP:0002092): Pulmonary hypertension is defined mean pulmonary artery pressure of 25mmHg or more and pulmonary capillary wedge pressure of 15mmHg or less when measured by right heart catheterisation at rest and in a supine position. Evidence: TAS. Frequency: Frequent (HP:0040282). (ORPHA:3287)
- Headache (HP:0002315): Cephalgia, or pain sensed in various parts of the head, not confined to the area of distribution of any nerve. Evidence: TAS. Frequency: Frequent (HP:0040282). (ORPHA:3287)
- Myalgia (HP:0003326): Pain in muscle. Evidence: TAS. Frequency: Frequent (HP:0040282). (ORPHA:3287)
- Elevated erythrocyte sedimentation rate (HP:0003565): An increased erythrocyte sedimentation rate (ESR). The ESR is a test that measures the distance that erythrocytes have fallen after one hour in a vertical column of anticoagulated blood under the influence of gravity. The ESR is a nonspecific finding. An elevation may indicate inflammation or may be caused by any condition that elevates fibrinogen. Evidence: TAS. Frequency: Frequent (HP:0040282). (ORPHA:3287)
- Intermittent claudication (HP:0004417): Intermittent claudication is a symptom of peripheral arterial occlusive disease. After having walked over a distance which is individually characteristic, the patients experience pain or cramps in the calves, feet or thighs which typically subsides on standing still. Evidence: TAS. Frequency: Frequent (HP:0040282). (ORPHA:3287)
- Ascending tubular aorta aneurysm (HP:0004970): An abnormal localized widening (dilatation) of the tubular part of the ascending aorta. Evidence: TAS. Frequency: Frequent (HP:0040282). (ORPHA:3287)
- Increased inflammatory response (HP:0012649): A abnormal increase in the inflammatory response to injury or infection. Evidence: TAS. Frequency: Frequent (HP:0040282). (ORPHA:3287)
- Blood pressure substantially higher in legs than arms (HP:0020141): An abnormal blood pressure discrepancy between the upper and lower extremities with the blood pressure measured in the legs being much higher than the blood pressure measure in the arms. In healthy individuals, ankle systolic blood pressures are only slightly higher than the systolic blood pressure measured in the arm. Evidence: TAS. Frequency: Frequent (HP:0040282). (ORPHA:3287)
- Absent pulse (HP:0032554): The pulsation of an artery where the pulse is taken (e.g. the radial artery at the wrist) cannot be detected on physical examination. Evidence: TAS. Frequency: Frequent (HP:0040282). (ORPHA:3287)
- Chest pain (HP:0100749): An unpleasant sensation characterized by physical discomfort (such as pricking, throbbing, or aching) localized to the chest. Evidence: TAS. Frequency: Frequent (HP:0040282). (ORPHA:3287)
- Gangrene (HP:0100758): A serious and potentially life-threatening condition that arises when a considerable mass of body tissue dies (necrosis). Evidence: TAS. Frequency: Frequent (HP:0040282). (ORPHA:3287)
- Skin ulcer (HP:0200042): A discontinuity of the skin exhibiting complete loss of the epidermis and often portions of the dermis and even subcutaneous fat. Evidence: TAS. Frequency: Frequent (HP:0040282). (ORPHA:3287)
- Carotidynia (HP:6000944): Pain or tenderness in the region of the carotid artery. Evidence: TAS. Frequency: Frequent (HP:0040282). (ORPHA:3287)
- Asymmetric blood pressure between arms (HP:6000945): A substantial difference in blood pressure (e.g., 20 mmHg) between the right and left arms. Evidence: TAS. Frequency: Frequent (HP:0040282). (ORPHA:3287)
- Retinopathy (HP:0000488): Any noninflammatory disease of the retina. This nonspecific term is retained here because of its wide use in the literature, but if possible new annotations should indicate the precise type of retinal abnormality. Evidence: TAS. Frequency: Occasional (HP:0040283). (ORPHA:3287)
- Visual impairment (HP:0000505): Visual impairment (or vision impairment) is vision loss (of a person) to such a degree as to qualify as an additional support need through a significant limitation of visual capability resulting from either disease, trauma, or congenital or degenerative conditions that cannot be corrected by conventional means, such as refractive correction, medication, or surgery. Evidence: TAS. Frequency: Occasional (HP:0040283). (ORPHA:3287)
- Stroke (HP:0001297): Sudden impairment of blood flow to a part of the brain due to occlusion or rupture of an artery to the brain. Evidence: TAS. Frequency: Occasional (HP:0040283). (ORPHA:3287)
- Congestive heart failure (HP:0001635): The presence of an abnormality of cardiac function that is responsible for the failure of the heart to pump blood at a rate that is commensurate with the needs of the tissues or a state in which abnormally elevated filling pressures are required for the heart to do so. Heart failure is frequently related to a defect in myocardial contraction. Evidence: TAS. Frequency: Occasional (HP:0040283). (ORPHA:3287)
- Dilated cardiomyopathy (HP:0001644): Dilated cardiomyopathy (DCM) is defined by the presence of left ventricular dilatation and left ventricular systolic dysfunction in the absence of abnormal loading conditions (hypertension, valve disease) or coronary artery disease sufficient to cause global systolic impairment. Right ventricular dilation and dysfunction may be present but are not necessary for the diagnosis. Evidence: TAS. Frequency: Occasional (HP:0040283). (ORPHA:3287)
- Aortic regurgitation (HP:0001659): An insufficiency of the aortic valve, leading to regurgitation (backward flow) of blood from the aorta into the left ventricle. Evidence: TAS. Frequency: Occasional (HP:0040283). (ORPHA:3287)
- Dyspnea (HP:0002094): Difficult or labored breathing. Dyspnea is a subjective feeling only the patient can rate, e.g., on a Borg scale. Evidence: TAS. Frequency: Occasional (HP:0040283). (ORPHA:3287)
- Hemoptysis (HP:0002105): Coughing up (expectoration) of blood or blood-streaked sputum from the larynx, trachea, bronchi, or lungs. Evidence: TAS. Frequency: Occasional (HP:0040283). (ORPHA:3287)
- Abnormal speech pattern (HP:0002167): An abnormality in the sound (volume) or cadence (rate) of speech. Evidence: TAS. Frequency: Occasional (HP:0040283). (ORPHA:3287)
- Vertigo (HP:0002321): An abnormal sensation of spinning while the body is actually stationary. Evidence: TAS. Frequency: Occasional (HP:0040283). (ORPHA:3287)
- Transient ischemic attack (HP:0002326). Evidence: TAS. Frequency: Occasional (HP:0040283). (ORPHA:3287)
- Cerebral ischemia (HP:0002637): Restriction of arterial blood supply to the brain associated with insufficient oxygenation to support the metabolic requirements of the tissue. Evidence: TAS. Frequency: Occasional (HP:0040283). (ORPHA:3287)
- Arthralgia (HP:0002829): Joint pain. Evidence: TAS. Frequency: Occasional (HP:0040283). (ORPHA:3287)
- Abnormal endocardium morphology (HP:0004306): An abnormality of the endocardium. Evidence: TAS. Frequency: Occasional (HP:0040283). (ORPHA:3287)
- Reduced consciousness (HP:0004372): Abnormally diminished level of attention, responsiveness, or wakefulness. Evidence: TAS. Frequency: Occasional (HP:0040283). (ORPHA:3287)
- Gastrointestinal infarctions (HP:0005244). Evidence: TAS. Frequency: Occasional (HP:0040283). (ORPHA:3287)
- Elevated circulating C-reactive protein concentration (HP:0011227): The concentration of C-reactive protein in the blood circulation is above the upper limit of normal. Evidence: TAS. Frequency: Occasional (HP:0040283). (ORPHA:3287)
- Erythema nodosum (HP:0012219): An erythematous eruption commonly associated with drug reactions or infection and characterized by inflammatory nodules that are usually tender, multiple, and bilateral. Evidence: TAS. Frequency: Occasional (HP:0040283). (ORPHA:3287)
- Night sweats (HP:0030166): Occurrence of excessive sweating during sleep. Evidence: TAS. Frequency: Occasional (HP:0040283). (ORPHA:3287)
- Malaise (HP:0033834): A feeling of general discomfort, weakness, or lack of health. Evidence: TAS. Frequency: Occasional (HP:0040283). (ORPHA:3287)
- Amaurosis fugax (HP:0100576): A transient visual disturbance that is typically caused by a circulatory, ocular or neurological underlying condition. Evidence: TAS. Frequency: Occasional (HP:0040283). (ORPHA:3287)
These phenotypes are associated with the disease Takayasu arteritis (ORPHA:3287).